- Paraparesis (HP:0002385): Weakness or partial paralysis in the lower limbs. Evidence: TAS. Frequency: Very frequent (HP:0040281). (ORPHA:101005)
- Herniation of intervertebral nuclei (HP:0008441): The presence of one or more herniated nucleus pulposus of intervertebral disk. Evidence: TAS. Frequency: Very frequent (HP:0040281). (ORPHA:101005)
- Sensory neuropathy (HP:0000763): Peripheral neuropathy affecting the sensory nerves. Evidence: TAS. Frequency: Frequent (HP:0040282). (ORPHA:101005)
- Spastic paraplegia (HP:0001258): Complete loss of the ability to move the lower limbs accompanied by spasticity of the lower limbs. Evidence: TAS. Frequency: Frequent (HP:0040282). (ORPHA:101005)
- Lower limb pain (HP:0012514): An unpleasant sensation characterized by physical discomfort (such as pricking, throbbing, or aching) localized to the leg. Evidence: TAS. Frequency: Frequent (HP:0040282). (ORPHA:101005)
- Neck pain (HP:0030833): An unpleasant sensation characterized by physical discomfort (such as pricking, throbbing, or aching) localized to the neck. Evidence: TAS. Frequency: Frequent (HP:0040282). (ORPHA:101005)
- Developmental cataract (HP:0000519): A cataract that occurs congenitally as the result of a developmental defect, in contrast to the majority of cataracts that occur in adulthood as the result of degenerative changes of the lens. Evidence: TAS. Frequency: Occasional (HP:0040283). (ORPHA:101005)
- Developmental glaucoma (HP:0001087): Glaucoma which forms during the early years of a child's life is called developmental or congenital glaucoma. Evidence: TAS. Frequency: Occasional (HP:0040283). (ORPHA:101005)
- Abnormality of peripheral nerve conduction (HP:0003134): An abnormality of the conduction of electrical impulses by peripheral (motor or sensory) nerves. This finding is elicited by a nerve conduction study (NCS). Evidence: TAS. Frequency: Occasional (HP:0040283). (ORPHA:101005)
- Sensorimotor neuropathy (HP:0007141). Evidence: TAS. Frequency: Occasional (HP:0040283). (ORPHA:101005)
- Cervical spondylosis (HP:0008480): Arthrosis, i.e., of degenerative joint disease, affecting the cervical vertebral column. Evidence: TAS. Frequency: Occasional (HP:0040283). (ORPHA:101005)
- Upper limb pain (HP:0012513): An unpleasant sensation characterized by physical discomfort (such as pricking, throbbing, or aching) localized to the arm. Evidence: TAS. Frequency: Occasional (HP:0040283). (ORPHA:101005)
- Abnormal lumbar spine morphology (HP:0100712): Any structural abnormality of the lumbar vertebral column. Evidence: TAS. Frequency: Occasional (HP:0040283). (ORPHA:101005)
These phenotypes are associated with the disease Autosomal recessive spastic paraplegia type 25 (ORPHA:101005).